- Abnormal vestibular function (HP:0001751, a Human Phenotype Ontology term): An abnormality of the functioning of the vestibular apparatus. Evidence: PCS. Frequency: 0/6. (PMID:17850630)
- Autosomal recessive inheritance (HP:0000007, a Human Phenotype Ontology term): A mode of inheritance that is observed for traits related to a gene encoded on one of the autosomes (i.e., the human chromosomes 1-22) in which a trait manifests in individuals with two pathogenic alleles, either homozygotes (two copies of the same mutant allele) or compound heterozygotes (whereby each copy of a gene has a distinct mutant allele). Evidence: PCS. (PMID:17850630)
- Rod-cone dystrophy (HP:0000510, a Human Phenotype Ontology term): An inherited retinal disease subtype in which the rod photoreceptors appear to be more severely affected than the cone photoreceptors. Typical presentation is with nyctalopia (due to rod dysfunction) followed by loss of mid-peripheral field of vision, which gradually extends and leaves many patients with a small central island of vision due to the preservation of macular cones. Evidence: PCS. Frequency: 0/6. (PMID:17850630)
- Prelingual sensorineural hearing impairment (HP:0000399, a Human Phenotype Ontology term): A form of sensorineural deafness with either congenital onset or infantile onset, i.e., before the acquisition of speech. Evidence: PCS. Frequency: 6/6. (PMID:17850630)
These phenotypes are associated with the disease autosomal recessive nonsyndromic hearing loss 12 (OMIM:601386, an entry in Online Mendelian Inheritance in Man).